- Dysphagia (HP:0002015): Difficulty in swallowing. Evidence: PCS. Frequency: 1/1. (PMID:16916845)
- Facial palsy (HP:0010628): Facial nerve palsy is a dysfunction of cranial nerve VII (the facial nerve) that results in inability to control facial muscles on the affected side with weakness of the muscles of facial expression and eye closure. This can either be present in unilateral or bilateral form. Evidence: PCS. Frequency: 1/1. (PMID:16916845)
- Increased muscle fatiguability (HP:0003750): An abnormal, increased fatiguability of the musculature. Evidence: PCS. Frequency: 1/1. (PMID:16916845)
- Feeding difficulties (HP:0011968): Impaired ability to eat related to problems gathering food and getting ready to suck, chew, or swallow it. Evidence: PCS. Frequency: 1/1. (PMID:16916845)
- Poor suck (HP:0002033): An inadequate sucking reflex, resulting in the difficult of newborns to be breast-fed. Evidence: PCS. Frequency: 1/1. (PMID:16916845)
- Hypotonia (HP:0001252): Hypotonia is an abnormally low muscle tone (the amount of tension or resistance to movement in a muscle). Even when relaxed, muscles have a continuous and passive partial contraction which provides some resistance to passive stretching. Hypotonia thus manifests as diminished resistance to passive stretching. Hypotonia is not the same as muscle weakness, although the two conditions can co-exist. Evidence: PCS. Frequency: 1/1. (PMID:16916845)
- Motor delay (HP:0001270): A type of Developmental delay characterized by a delay in acquiring motor skills. Evidence: PCS. Frequency: 1/1. (PMID:16916845)
- Respiratory insufficiency (HP:0002093). Evidence: PCS. Frequency: 1/1. (PMID:16916845)
- Weakness of facial musculature (HP:0030319): Reduced strength of one or more muscles innervated by the facial nerve (the seventh cranial nerve). Evidence: PCS. Frequency: 1/1. (PMID:16916845)
- Anti-neuromuscular Junction acetylcholine receptor antibody positivity (HP:0030208): The presence of autoantibodies (immunoglobulins) in the blood circulation that react against neuromuscular junction acetylcholine receptors. Evidence: PCS. Frequency: 0/1. (PMID:16916845)
- Ptosis (HP:0000508): The upper eyelid margin is positioned 3 mm or more lower than usual and covers the superior portion of the iris (objective); or, the upper lid margin obscures at least part of the pupil (subjective). Evidence: PCS. Frequency: 1/1. (PMID:16916845)
- Autosomal recessive inheritance (HP:0000007): A mode of inheritance that is observed for traits related to a gene encoded on one of the autosomes (i.e., the human chromosomes 1-22) in which a trait manifests in individuals with two pathogenic alleles, either homozygotes (two copies of the same mutant allele) or compound heterozygotes (whereby each copy of a gene has a distinct mutant allele). Evidence: PCS. (PMID:16916845)
- High palate (HP:0000218): Height of the palate more than 2 SD above the mean (objective) or palatal height at the level of the first permanent molar more than twice the height of the teeth (subjective). Evidence: PCS. Frequency: 1/1. (PMID:16916845)
- Neonatal onset (HP:0003623): Onset of signs or symptoms of disease within the first 28 days of life. Evidence: PCS. Frequency: 1/1. (PMID:16916845)
These phenotypes are associated with the disease congenital myasthenic syndrome 3C (OMIM:616323).